Phenotypes associated with the disease autosomal recessive nonsyndromic hearing loss 27 (OMIM:605818):
- Sensorineural hearing impairment (HP:0000407): A type of hearing impairment in one or both ears related to an abnormal functionality of the cochlear nerve. Evidence: TAS. (OMIM:605818)
- Autosomal recessive inheritance (HP:0000007): A mode of inheritance that is observed for traits related to a gene encoded on one of the autosomes (i.e., the human chromosomes 1-22) in which a trait manifests in individuals with two pathogenic alleles, either homozygotes (two copies of the same mutant allele) or compound heterozygotes (whereby each copy of a gene has a distinct mutant allele). Evidence: TAS. (OMIM:605818)